- Abnormal hair morphology (HP:0001595): An abnormality of the hair. Evidence: PCS. Frequency: 0/5. (PMID:16333316)
- Juvenile onset (HP:0003621): Onset of signs or symptoms of disease between the age of 5 and 15 years. Evidence: PCS. (PMID:10615120)
- Abnormal fingernail morphology (HP:0001231): An abnormality of the fingernails. Evidence: PCS. Frequency: 0/5. (PMID:16333316)
- Anhidrosis (HP:0000970): Inability to sweat. Evidence: PCS. Frequency: 0/5. (PMID:16333316)
- Microdontia (HP:0000691): Decreased size of the teeth, which can be defined as a mesiodistal tooth diameter (width) more than 2 SD below mean. Alternatively, an apparently decreased maximum width of tooth. Evidence: TAS. Frequency: Occasional (HP:0040283). (OMIM:604625)
- Agenesis of permanent molar (HP:0011055): Agenesis of secondary molar tooth. Evidence: PCS. Frequency: 16/16. (PMID:10615120)
- Abnormal skin morphology (HP:0011121): Any morphological abnormality of the skin. Evidence: PCS. Frequency: 0/5. (PMID:16333316)
- Oligodontia of primary teeth (HP:0012225): Reduced number of primary teeth. Evidence: PCS. Frequency: 0/16. (PMID:10615120)
- Autosomal dominant inheritance (HP:0000006): A mode of inheritance that is observed for traits related to a gene encoded on one of the autosomes (i.e., the human chromosomes 1-22) in which a trait manifests in heterozygotes. In the context of medical genetics, an autosomal dominant disorder is caused when a single copy of the mutant allele is present. Males and females are affected equally, and can both transmit the disorder with a risk of 50% for each child of inheriting the mutant allele. Evidence: PCS. (PMID:10615120)
- Oligodontia (HP:0000677): The absence of six or more teeth from the normal series by a failure to develop. Evidence: PCS. Frequency: 16/16. (PMID:10615120)
These phenotypes are associated with the disease tooth agenesis, selective, 3 (OMIM:604625).